Phenotypes associated with the disease Guillain-Barre syndrome, familial (OMIM:139393):
- Acute demyelinating polyneuropathy (HP:0007131): Acute progressive areflexic weakness and mild sensory changes resulting from myelin breakdown and axonal degeneration. Evidence: PCS. (PMID:12439896)
- Autosomal dominant inheritance (HP:0000006): A mode of inheritance that is observed for traits related to a gene encoded on one of the autosomes (i.e., the human chromosomes 1-22) in which a trait manifests in heterozygotes. In the context of medical genetics, an autosomal dominant disorder is caused when a single copy of the mutant allele is present. Males and females are affected equally, and can both transmit the disorder with a risk of 50% for each child of inheriting the mutant allele. Evidence: PCS. (PMID:12439896)